- Insidious onset (HP:0003587): Gradual, very slow onset of disease manifestations. Evidence: PCS. (PMID:23455931)
- Progressive (HP:0003676): Applies to a disease manifestation that increases in scope or severity over the course of time, i.e., that worsens with age. Evidence: PCS. (PMID:23455931)
- Dysphagia (HP:0002015): Difficulty in swallowing. Evidence: PCS. Frequency: 4/10. (PMID:23455931)
- Impaired vibration sensation in the lower limbs (HP:0002166): A decrease in the ability to perceive vibration in the legs. Evidence: PCS. Frequency: 10/10. (PMID:23455931)
- Middle age onset (HP:0003596): A type of adult onset with onset of symptoms at the age of 40 to 60 years. Evidence: PCS. Frequency: 3/10. (PMID:23455931)
- Babinski sign (HP:0003487): Upturning of the big toe (and sometimes fanning of the other toes) in response to stimulation of the sole of the foot. If the Babinski sign is present it can indicate damage to the corticospinal tract. Evidence: PCS. Frequency: 10/10. (PMID:23455931)
- Pes cavus (HP:0001761): An increase in height of the medial longitudinal arch of the foot that does not flatten on weight bearing (i.e., a distinctly hollow form of the sole of the foot when it is bearing weight). Evidence: PCS. Frequency: 1/10. (PMID:23455931)
- Urinary urgency (HP:0000012): Urge incontinence is the strong, sudden need to urinate. Evidence: PCS. Frequency: 8/10. (PMID:23455931)
- Lower limb hyperreflexia (HP:0002395): Increased intensity of the a reflex in the leg. Evidence: PCS. Frequency: 10/10. (PMID:23455931)
- Dysarthria (HP:0001260): Dysarthric speech is a general description referring to a neurological speech disorder characterized by poor articulation. Depending on the involved neurological structures, dysarthria may be further classified as spastic, flaccid, ataxic, hyperkinetic and hypokinetic, or mixed. Evidence: PCS. Frequency: 0/10. (PMID:23455931)
- Urinary incontinence (HP:0000020): Loss of the ability to control the urinary bladder leading to involuntary urination. Evidence: IEA. (OMIM:603563)
- Spastic gait (HP:0002064): Spasticity is manifested by increased stretch reflex which is intensified with movement velocity. This results in excessive and inappropriate muscle activation which can contribute to muscle hypertonia. Spastic gait is characterized by manifestations such as muscle hypertonia, stiff knee, and circumduction of the leg. Evidence: PCS. (PMID:23455931)
- Lower limb spasticity (HP:0002061): Spasticity (velocity-dependent increase in tonic stretch reflexes with increased muscle tone and hyperexcitable tendon reflexes) in the muscles of the lower limbs, hips, and pelvis. Evidence: PCS. Frequency: 10/10. (PMID:23455931)
- Upper limb hyperreflexia (HP:0007350): Increased intensity of the a reflex in the arm. Evidence: PCS. Frequency: 8/10. (PMID:23455931)
- Lower limb muscle weakness (HP:0007340): Weakness of the muscles of the legs. Evidence: PCS. Frequency: 8/10. (PMID:23455931)
- Young adult onset (HP:0011462): Onset of disease at the age of between 16 and 40 years. Evidence: PCS. Frequency: 7/10. (PMID:23455931)
- Urinary bladder sphincter dysfunction (HP:0002839): Abnormal function of a sphincter of the urinary bladder. Evidence: IEA. (OMIM:603563)
- Low back pain (HP:0003419): An unpleasant sensation characterized by physical discomfort (such as pricking, throbbing, or aching) localized to the lower back. Evidence: PCS. Frequency: 4/10. (PMID:23455931)
- Spastic paraplegia (HP:0001258): Complete loss of the ability to move the lower limbs accompanied by spasticity of the lower limbs. Evidence: PCS. Frequency: 10/10. (PMID:23455931)
- Autosomal dominant inheritance (HP:0000006): A mode of inheritance that is observed for traits related to a gene encoded on one of the autosomes (i.e., the human chromosomes 1-22) in which a trait manifests in heterozygotes. In the context of medical genetics, an autosomal dominant disorder is caused when a single copy of the mutant allele is present. Males and females are affected equally, and can both transmit the disorder with a risk of 50% for each child of inheriting the mutant allele. Evidence: PCS. (PMID:17160902)
- Upper limb spasticity (HP:0006986). Evidence: TAS. Frequency: Occasional (HP:0040283). (OMIM:603563)
- Degeneration of the lateral corticospinal tracts (HP:0002314): Deterioration of the tissues of the lateral corticospinal tracts. Evidence: IEA. (OMIM:603563)
- Hyperreflexia (HP:0001347): Hyperreflexia is the presence of hyperactive stretch reflexes of the muscles. Evidence: IEA. (OMIM:603563)
These phenotypes are associated with the disease hereditary spastic paraplegia 8 (OMIM:603563).